- Autoimmunity (HP:0002960): The occurrence of an immune reaction against the organism's own cells or tissues. Evidence: PCS. (PMID:6465701)
- Urticaria (HP:0001025): Raised, well-circumscribed areas of erythema and edema involving the dermis and epidermis. Urticaria is intensely pruritic, and blanches completely with pressure. Evidence: PCS. (PMID:6465701)
- Abnormality of blood and blood-forming tissues (HP:0001871): An abnormality of the hematopoietic system. Evidence: IEA. (OMIM:131430)
- Decreased total eosinophil count (HP:0031891): Abnormal decrease of absolute number of eosinophils in the blood, per microlitre, compared to a reference range for a given sex and age-group. Evidence: PCS. (PMID:6465701)
- Allergic rhinitis (HP:0003193): It is characterized by one or more symptoms including sneezing, itching, nasal congestion, and rhinorrhea. Evidence: PCS. (PMID:6465701)
These phenotypes are associated with the disease Eosinophilopenia (OMIM:131430).